- Hypopituitarism (HP:0040075). Evidence: TAS. Frequency: Obligate (HP:0040280). (ORPHA:91350)
- Visual impairment (HP:0000505): Visual impairment (or vision impairment) is vision loss (of a person) to such a degree as to qualify as an additional support need through a significant limitation of visual capability resulting from either disease, trauma, or congenital or degenerative conditions that cannot be corrected by conventional means, such as refractive correction, medication, or surgery. Evidence: TAS. Frequency: Frequent (HP:0040282). (ORPHA:91350)
- Increased circulating prolactin concentration (HP:0000870): The presence of abnormally increased levels of prolactin in the blood. Prolactin is a peptide hormone produced by the anterior pituitary gland that plays a role in breast development and lactation during pregnancy. Evidence: TAS. Frequency: Frequent (HP:0040282). (ORPHA:91350)
- Slow decrease in visual acuity (HP:0007924). Evidence: TAS. Frequency: Frequent (HP:0040282). (ORPHA:91350)
- Enlarged pituitary gland (HP:0012505): An abnormally increased size of the pituitary gland. Evidence: TAS. Frequency: Frequent (HP:0040282). (ORPHA:91350)
- Bitemporal hemianopia (HP:0030521). Evidence: TAS. Frequency: Frequent (HP:0040282). (ORPHA:91350)
- Abnormal kinetic perimetry test (HP:0030591). Evidence: TAS. Frequency: Frequent (HP:0040282). (ORPHA:91350)
- Hypogonadotropic hypogonadism (HP:0000044): Hypogonadotropic hypogonadism is characterized by reduced function of the gonads (testes in males or ovaries in females) and results from the absence of the gonadal stimulating pituitary hormones: follicle stimulating hormone (FSH) and luteinizing hormone (LH). Evidence: TAS. Frequency: Occasional (HP:0040283). (ORPHA:91350)
- Hydrocephalus (HP:0000238): Hydrocephalus is an active distension of the ventricular system of the brain resulting from inadequate passage of CSF from its point of production within the cerebral ventricles to its point of absorption into the systemic circulation. Evidence: TAS. Frequency: Occasional (HP:0040283). (ORPHA:91350)
- Anterior hypopituitarism (HP:0000830): A condition of reduced function of the anterior pituitary gland characterized by decreased secretion of one or more of the pituitary hormones growth hormone, thyroid-stimulating hormone, adrenocorticotropic hormone, prolactin, luteinizing hormone, and follicle-stimulating hormone. Evidence: TAS. Frequency: Occasional (HP:0040283). (ORPHA:91350)
- Panhypopituitarism (HP:0000871): A pituitary functional deficit affecting all the anterior pituitary hormones (growth hormone, thyroid-stimulating hormone, follicle-stimulating hormone, luteinizing hormone, adrenocorticotropic hormone, and prolactin). Evidence: TAS. Frequency: Occasional (HP:0040283). (ORPHA:91350)
- Headache (HP:0002315): Cephalgia, or pain sensed in various parts of the head, not confined to the area of distribution of any nerve. Evidence: TAS. Frequency: Occasional (HP:0040283). (ORPHA:91350)
- Increased intracranial pressure (HP:0002516): An increase of the pressure inside the cranium (skull) and thereby in the brain tissue and cerebrospinal fluid. Evidence: TAS. Frequency: Occasional (HP:0040283). (ORPHA:91350)
- Optic nerve compression (HP:0007807). Evidence: TAS. Frequency: Occasional (HP:0040283). (ORPHA:91350)
- Secondary growth hormone deficiency (HP:0008240). Evidence: TAS. Frequency: Occasional (HP:0040283). (ORPHA:91350)
- Adrenocorticotropin deficient adrenal insufficiency (HP:0011735): Adrenal insufficiency secondary to a defect in ACTH production. Evidence: TAS. Frequency: Occasional (HP:0040283). (ORPHA:91350)
- Oculomotor nerve palsy (HP:0012246): Reduced ability to control the movement of the eye associated with damage to the third cranial nerve (the oculomotor nerve). Evidence: TAS. Frequency: Occasional (HP:0040283). (ORPHA:91350)
- Diplopia (HP:0000651): Diplopia is a condition in which a single object is perceived as two images, it is also known as double vision. Evidence: TAS. Frequency: Very rare (HP:0040284). (ORPHA:91350)
- Diabetes insipidus (HP:0000873): A state of excessive water intake and hypotonic (dilute) polyuria. Diabetes insipidus may be due to failure of vasopressin (AVP) release (central or neurogenic diabetes insipidus) or to a failure of the kidney to respond to AVP (nephrogenic diabetes insipidus). Evidence: TAS. Frequency: Very rare (HP:0040284). (ORPHA:91350)
- Intracranial hemorrhage (HP:0002170): Hemorrhage occurring within the skull. Evidence: TAS. Frequency: Very rare (HP:0040284). (ORPHA:91350)
- Reduced consciousness (HP:0004372): Abnormally diminished level of attention, responsiveness, or wakefulness. Evidence: TAS. Frequency: Very rare (HP:0040284). (ORPHA:91350)
- Pituitary hypothyroidism (HP:0008245): A type of hypothyroidism that results from a defect in thyroid-stimulating hormone secretion. Evidence: TAS. Frequency: Very rare (HP:0040284). (ORPHA:91350)
- Thunderclap headache (HP:0030907): Severe head pain with sudden onset, reaching its maximum intensity in less than one minute and lasting from one hour to ten days. Evidence: TAS. Frequency: Very rare (HP:0040284). (ORPHA:91350)
- Abnormality of the sphenoid sinus (HP:0430022): An abnormality of the sphenoid sinus, one of the mucosa-lined, normally air-filled paranasal sinuses of the bones of the skull. The sphenoid sinus is located within the sphenoid bone. Evidence: TAS. Frequency: Very rare (HP:0040284). (ORPHA:91350)
These phenotypes are associated with the disease Pituitary deficiency due to Rathke cleft cysts (ORPHA:91350).